- Juvenile onset (HP:0003621): Onset of signs or symptoms of disease between the age of 5 and 15 years. Evidence: PCS. Frequency: 1/1. (PMID:31781092)
- Autosomal recessive inheritance (HP:0000007): A mode of inheritance that is observed for traits related to a gene encoded on one of the autosomes (i.e., the human chromosomes 1-22) in which a trait manifests in individuals with two pathogenic alleles, either homozygotes (two copies of the same mutant allele) or compound heterozygotes (whereby each copy of a gene has a distinct mutant allele). Evidence: PCS. (PMID:31781092)
- Palmar warts (HP:0033004): Multiple verrucous lesions on the skin of the palm. These lesions are raised, have a thickened and rough surface, and may display prominent black dots (thrombosed capillaries). Palmar warts are caused by human papillomavirus (HPV). Evidence: PCS. Frequency: 1/1. (PMID:31781092)
- Recurrent otitis media (HP:0000403): Increased susceptibility to otitis media, as manifested by recurrent episodes of otitis media. Evidence: PCS. Frequency: 1/1. (PMID:33471124)
- Plantar warts (HP:0033005): Multiple verrucous lesions on the skin of the sole of the foot. These lesions are raised, have a thickened and rough surface, and may display prominent black dots (thrombosed capillaries). Palmar warts are caused by caused by human papillomavirus (HPV). Evidence: PCS. Frequency: 1/1. (PMID:31781092)
- Recurrent upper respiratory tract infections (HP:0002788): An increased susceptibility to upper respiratory tract infections as manifested by a history of recurrent upper respiratory tract infections (running ears - otitis, sinusitis, pharyngitis, tonsillitis). Evidence: PCS. Frequency: 1/1. (PMID:33471124)
- Disseminated cutaneous warts (HP:0032215): Multiple skin warts located in multiple parts of the body, e.g., neck, trunks, and extremities. Evidence: IEA. Frequency: 1/1. (PMID:33471124)
- Decreased total CD4+ T cell proportion (HP:0032218): Abnormal decrease of helper CD3+CD4+ T cells, measured as percentage of total CD3+ T cells in the blood, compared to a reference range for a given sex and age-group. These are usually measured within the TCR alpha/beta positive population. Evidence: PCS. Frequency: 1/1. (PMID:31781092)
These phenotypes are associated with the disease immunodeficiency 79 (OMIM:619238).